Phenotypes associated with the disease premature ovarian failure 26 (OMIM:621065):
- Premature ovarian insufficiency (HP:0008209): Amenorrhea due to loss of ovarian function before the age of 40. Primary ovarian insuficiency (POI) is a state of female hypergonadotropic hypogonadism. It can manifest as primary amenorrhea with onset before menarche or secondary amenorrhea. Evidence: PCS. (PMID:39545409)
- Secondary amenorrhea (HP:0000869). Evidence: PCS. Frequency: 23/28. (PMID:39545409)
- Elevated circulating luteinizing hormone level (HP:0011969): An elevated concentration of luteinizing hormone in the blood. Evidence: PCS. (PMID:39545409)
- Female infertility (HP:0008222). Evidence: PCS. (PMID:39545409)
- Elevated circulating follicle stimulating hormone level (HP:0008232): An elevated concentration of follicle-stimulating hormone in the blood. Evidence: PCS. (PMID:39545409)
- Decreased serum estradiol (HP:0008214): A reduction below normal concentration of estradiol in the circulation. Evidence: PCS. (PMID:39545409)
- Autosomal dominant inheritance (HP:0000006): A mode of inheritance that is observed for traits related to a gene encoded on one of the autosomes (i.e., the human chromosomes 1-22) in which a trait manifests in heterozygotes. In the context of medical genetics, an autosomal dominant disorder is caused when a single copy of the mutant allele is present. Males and females are affected equally, and can both transmit the disorder with a risk of 50% for each child of inheriting the mutant allele. Evidence: PCS. (PMID:39545409)
- Primary amenorrhea (HP:0000786). Evidence: PCS. Frequency: 5/28. (PMID:39545409)